- Axial hypotonia (HP:0008936): Muscular hypotonia (abnormally low muscle tone) affecting the musculature of the trunk. Evidence: PCS. Frequency: 1/1. (PMID:20833646)
- Epileptic spasm (HP:0011097): A sudden flexion, extension, or mixed extension-flexion of predominantly proximal and truncal muscles that is usually more sustained than a myoclonic movement but not as sustained as a tonic seizure. Limited forms may occur: Grimacing, head nodding, or subtle eye movements. Epileptic spasms frequently occur in clusters. Infantile spasms are the best known form, but spasms can occur at all ages. Evidence: PCS. Frequency: 1/1. (PMID:20833646)
- Bilateral tonic-clonic seizure (HP:0002069): A bilateral tonic-clonic seizure is a seizure defined by a tonic (bilateral increased tone, lasting seconds to minutes) and then a clonic (bilateral sustained rhythmic jerking) phase. Evidence: PCS. Frequency: 1/1. Onset: Childhood onset (HP:0011463). (PMID:20833646)
- Hypsarrhythmia (HP:0002521): Hypsarrhythmia is abnormal interictal high amplitude waves and a background of irregular spikes. There is continuous (during wakefulness), high-amplitude (>200 Hz), generalized polymorphic slowing with no organized background and multifocal spikes demonstrated by electroencephalography (EEG). Evidence: PCS. Frequency: 1/1. (PMID:20833646)
- Developmental regression (HP:0002376): Loss of developmental skills, as manifested by loss of developmental milestones. Evidence: PCS. Frequency: 1/1. Onset: Childhood onset (HP:0011463). (PMID:20833646)
- Tonic seizure (HP:0032792): A tonic seizure is a type of motor seizure characterized by unilateral or bilateral limb stiffening or elevation, often with neck stiffening. Evidence: PCS. Frequency: 1/1. Onset: Childhood onset (HP:0011463). (PMID:20833646)
- Infantile onset (HP:0003593): Onset of signs or symptoms of disease between 28 days to one year of life. Evidence: PCS. Frequency: 1/1. (PMID:20833646)
- Autosomal recessive inheritance (HP:0000007): A mode of inheritance that is observed for traits related to a gene encoded on one of the autosomes (i.e., the human chromosomes 1-22) in which a trait manifests in individuals with two pathogenic alleles, either homozygotes (two copies of the same mutant allele) or compound heterozygotes (whereby each copy of a gene has a distinct mutant allele). Evidence: PCS. (PMID:20833646)
- Epileptic encephalopathy (HP:0200134): A condition in which epileptiform abnormalities are believed to contribute to the progressive disturbance in cerebral function. Epileptic encephalaopathy is characterized by (1) electrographic EEG paroxysmal activity that is often aggressive, (2) seizures that are usually multiform and intractable, (3) cognitive, behavioral and neurological deficits that may be relentless, and (4) sometimes early death. Evidence: PCS. Frequency: 1/1. (PMID:20833646)
- Focal-onset seizure (HP:0007359): A focal-onset seizure is a type of seizure originating within networks limited to one hemisphere. They may be discretely localized or more widely distributed, and may originate in subcortical structures. Evidence: PCS. Frequency: 1/1. (PMID:20833646)
- Spasticity (HP:0001257): A motor disorder characterized by a velocity-dependent increase in tonic stretch reflexes with increased muscle tone, exaggerated (hyperexcitable) tendon reflexes. Evidence: PCS. Frequency: 1/1. (PMID:20833646)
- Hyperreflexia (HP:0001347): Hyperreflexia is the presence of hyperactive stretch reflexes of the muscles. Evidence: TAS. (OMIM:613722)
These phenotypes are associated with the disease developmental and epileptic encephalopathy, 12 (OMIM:613722).